- Young adult onset (HP:0011462): Onset of disease at the age of between 16 and 40 years. Evidence: PCS. (PMID:11506076)
- Recurrent spontaneous abortion (HP:0200067): Repeated episodes of abortion (Expulsion of the product of fertilization before completing the term of gestation) without deliberate interference. Evidence: PCS. (PMID:11506076)
- Autosomal dominant inheritance (HP:0000006): A mode of inheritance that is observed for traits related to a gene encoded on one of the autosomes (i.e., the human chromosomes 1-22) in which a trait manifests in heterozygotes. In the context of medical genetics, an autosomal dominant disorder is caused when a single copy of the mutant allele is present. Males and females are affected equally, and can both transmit the disorder with a risk of 50% for each child of inheriting the mutant allele. Evidence: PCS. (PMID:11506076)
These phenotypes are associated with the disease pregnancy loss, recurrent, susceptibility to, 2 (OMIM:614390).